- Palmoplantar cutis laxa (HP:0007517): Loose, wrinkled skin of hands and feet. Evidence: PCS. Frequency: 1/2. (PMID:28289718)
- Short stature (HP:0004322): A height below that which is expected according to age and gender norms. Although there is no universally accepted definition of short stature, many refer to "short stature" as height more than 2 standard deviations below the mean for age and gender (or below the 3rd percentile for age and gender dependent norms). Evidence: PCS. Frequency: 2/3. (PMID:31173466;PMID:28289718)
- Hypotonia (HP:0001252): Hypotonia is an abnormally low muscle tone (the amount of tension or resistance to movement in a muscle). Even when relaxed, muscles have a continuous and passive partial contraction which provides some resistance to passive stretching. Hypotonia thus manifests as diminished resistance to passive stretching. Hypotonia is not the same as muscle weakness, although the two conditions can co-exist. Evidence: PCS. Frequency: 1/2. (PMID:28289718)
- Relative macrocephaly (HP:0004482): A relatively mild degree of macrocephaly in which the head circumference is not above two standard deviations from the mean, but appears dysproportionately large when other factors such as body stature are taken into account. Evidence: PCS. Frequency: 1/1. (PMID:31173466)
- Thick vermilion border (HP:0012471): Increased width of the skin of vermilion border region of upper lip. Evidence: PCS. Frequency: 1/1. (PMID:31173466)
- Hypertelorism (HP:0000316): Interpupillary distance more than 2 SD above the mean (alternatively, the appearance of an increased interpupillary distance or widely spaced eyes). Evidence: PCS. Frequency: 1/1. (PMID:31173466)
- Bulbous nose (HP:0000414): Increased volume and globular shape of the anteroinferior aspect of the nose. Evidence: PCS. Frequency: 1/1. (PMID:31173466)
- Feeding difficulties in infancy (HP:0008872): Impaired feeding performance of an infant as manifested by difficulties such as weak and ineffective sucking, brief bursts of sucking, and falling asleep during sucking. There may be difficulties with chewing or maintaining attention. Evidence: PCS. Frequency: 1/1. (PMID:31173466)
- Pulmonic stenosis (HP:0001642): A narrowing of the right ventricular outflow tract that can occur at the pulmonary valve (valvular stenosis), below the pulmonary valve (infundibular stenosis), or above the pulmonary valve (supravalvar stenosis). Evidence: PCS. Frequency: 1/2. (PMID:28289718)
- Posteriorly rotated ears (HP:0000358): A type of abnormal location of the ears in which the position of the ears is characterized by posterior rotation (the superior part of the ears is rotated towards the back of the head, and the inferior part of the ears towards the front). Evidence: PCS. Frequency: 2/2. (PMID:28289718)
- Downslanted palpebral fissures (HP:0000494): The palpebral fissure inclination is more than two standard deviations below the mean. Evidence: PCS. Frequency: 1/1. (PMID:31173466)
- Bilateral sensorineural hearing impairment (HP:0008619): A form of sensorineural hearing impairment that affects both ears. Evidence: PCS. Frequency: 1/1. (PMID:31173466)
- Delayed speech and language development (HP:0000750): A degree of language development that is significantly below the norm for a child of a specified age. Evidence: PCS. Frequency: 1/1. (PMID:31173466)
- Delayed ability to walk (HP:0031936): A failure to achieve the ability to walk at an appropriate developmental stage. Most children learn to walk in a series of stages, and learn to walk short distances independently between 12 and 15 months. Evidence: PCS. Frequency: 1/1. (PMID:31173466)
- Long face (HP:0000276): Facial height (length) is more than 2 standard deviations above the mean (objective); or, an apparent increase in the height (length) of the face (subjective). Evidence: PCS. Frequency: 1/2. (PMID:28289718)
- Global developmental delay (HP:0001263): A delay in the achievement of motor or mental milestones in the domains of development of a child, including motor skills, speech and language, cognitive skills, and social and emotional skills. This term should only be used to describe children younger than five years of age. Evidence: PCS. Frequency: 3/3. (PMID:31173466;PMID:28289718)
- Depressed nasal bridge (HP:0005280): Posterior positioning of the nasal root in relation to the overall facial profile for age. Evidence: PCS. Frequency: 1/1. (PMID:31173466)
- Hypertrophic cardiomyopathy (HP:0001639): Hypertrophic cardiomyopathy (HCM) is defined by the presence of increased ventricular wall thickness or mass in the absence of loading conditions (hypertension, valve disease) sufficient to cause the observed abnormality. Evidence: PCS. Frequency: 2/3. (PMID:31173466;PMID:28289718)
- Ptosis (HP:0000508): The upper eyelid margin is positioned 3 mm or more lower than usual and covers the superior portion of the iris (objective); or, the upper lid margin obscures at least part of the pupil (subjective). Evidence: PCS. Frequency: 1/2. (PMID:28289718)
- Pectus excavatum (HP:0000767): A defect of the chest wall characterized by a depression of the sternum, giving the chest ("pectus") a caved-in ("excavatum") appearance. Evidence: PCS. Frequency: 1/2. (PMID:28289718)
- High forehead (HP:0000348): An abnormally increased height of the forehead. Evidence: PCS. Frequency: 1/2. (PMID:28289718)
- Pointed chin (HP:0000307): A marked tapering of the lower face to the chin. Evidence: PCS. Frequency: 1/2. (PMID:28289718)
- Atrial septal defect (HP:0001631): Atrial septal defect (ASD) is a congenital abnormality of the interatrial septum that enables blood flow between the left and right atria via the interatrial septum. Evidence: PCS. Frequency: 1/2. (PMID:28289718)
- Autosomal dominant inheritance (HP:0000006): A mode of inheritance that is observed for traits related to a gene encoded on one of the autosomes (i.e., the human chromosomes 1-22) in which a trait manifests in heterozygotes. In the context of medical genetics, an autosomal dominant disorder is caused when a single copy of the mutant allele is present. Males and females are affected equally, and can both transmit the disorder with a risk of 50% for each child of inheriting the mutant allele. Evidence: PCS. (PMID:31173466)
- Low-set ears (HP:0000369): Upper insertion of the ear to the scalp below an imaginary horizontal line drawn between the inner canthi of the eye and extending posteriorly to the ear. Evidence: PCS. Frequency: 3/3. (PMID:31173466;PMID:28289718)
These phenotypes are associated with the disease Noonan syndrome 11 (OMIM:618499).